- Hyperhidrosis (HP:0000975): Abnormal excessive perspiration (sweating) despite the lack of appropriate stimuli like hot and humid weather. Evidence: TAS. (OMIM:144100)
- Autosomal dominant inheritance (HP:0000006): A mode of inheritance that is observed for traits related to a gene encoded on one of the autosomes (i.e., the human chromosomes 1-22) in which a trait manifests in heterozygotes. In the context of medical genetics, an autosomal dominant disorder is caused when a single copy of the mutant allele is present. Males and females are affected equally, and can both transmit the disorder with a risk of 50% for each child of inheriting the mutant allele. Evidence: IEA. (OMIM:144100)
These phenotypes are associated with the disease Frey syndrome (OMIM:144100).